Phenotypes associated with the disease periventricular nodular heterotopia 8 (OMIM:618185):
- Delayed speech and language development (HP:0000750): A degree of language development that is significantly below the norm for a child of a specified age. Evidence: PCS. Frequency: 1/2. (PMID:28868155)
- Delayed CNS myelination (HP:0002188): Delayed myelination in the central nervous system. Evidence: PCS. Frequency: 1/2. (PMID:28868155)
- Reduced cerebral white matter volume (HP:0034295): An abnormally low volume of the white matter of the brain. Evidence: PCS. Frequency: 1/2. (PMID:28868155)
- Seizure (HP:0001250): A seizure is an intermittent abnormality of nervous system physiology characterized by a transient occurrence of signs and/or symptoms due to abnormal excessive or synchronous neuronal activity in the brain. Evidence: PCS. Frequency: 2/3. (PMID:28868155)
- Global developmental delay (HP:0001263): A delay in the achievement of motor or mental milestones in the domains of development of a child, including motor skills, speech and language, cognitive skills, and social and emotional skills. This term should only be used to describe children younger than five years of age. Evidence: PCS. Frequency: 2/2. (PMID:28868155)
- Periventricular nodular heterotopia (HP:0032388): Nodules of heterotopia along the ventricular walls. There can be a single nodule or a large number of nodules, they can exist on either or both sides of the brain at any point along the higher ventricle margins, they can be small or large, single or multiple. Evidence: PCS. Frequency: 2/3. (PMID:28868155)
- Spasticity (HP:0001257): A motor disorder characterized by a velocity-dependent increase in tonic stretch reflexes with increased muscle tone, exaggerated (hyperexcitable) tendon reflexes. Evidence: PCS. Frequency: 1/2. (PMID:28868155)
- Autosomal dominant inheritance (HP:0000006): A mode of inheritance that is observed for traits related to a gene encoded on one of the autosomes (i.e., the human chromosomes 1-22) in which a trait manifests in heterozygotes. In the context of medical genetics, an autosomal dominant disorder is caused when a single copy of the mutant allele is present. Males and females are affected equally, and can both transmit the disorder with a risk of 50% for each child of inheriting the mutant allele. Evidence: PCS. (PMID:28868155)
- Cerebellar vermis atrophy (HP:0006855): Wasting (atrophy) of the vermis of cerebellum. Evidence: PCS. Frequency: 1/2. (PMID:28868155)